Phenotypes associated with the disease nephrotic syndrome, type 13 (OMIM:616893):
- Stage 5 chronic kidney disease (HP:0003774): A degree of kidney failure severe enough to require dialysis or kidney transplantation for survival characterized by a severe reduction in glomerular filtration rate (less than 15 ml/min/1.73 m2) and other manifestations including increased serum creatinine. Evidence: PCS. (PMID:26878725)
- Focal segmental glomerulosclerosis (HP:0000097): Segmental accumulation of scar tissue in individual (but not all) glomeruli. Evidence: PCS. (PMID:26878725)
- Autosomal recessive inheritance (HP:0000007): A mode of inheritance that is observed for traits related to a gene encoded on one of the autosomes (i.e., the human chromosomes 1-22) in which a trait manifests in individuals with two pathogenic alleles, either homozygotes (two copies of the same mutant allele) or compound heterozygotes (whereby each copy of a gene has a distinct mutant allele). Evidence: PCS. (PMID:26878725)
- Steroid-resistant nephrotic syndrome (HP:0012588): A form of nephrotic syndrome that does not respond to treatment with steroid medication, defined as persistent proteinuria despite 60mg/m2 or 2mg/kg for 8 weeks, after insuring no infection or non-adherence to medication. Evidence: PCS. (PMID:26878725)